Phenotypes associated with the disease leishmaniasis, tegumentary, susceptibility to (OMIM:602068):
- Tegumentary leishmaniasis susceptibility (HP:0007408): Increased susceptibility to infection by the protozan parasite of the genus Leishmania. Evidence: IEA. (OMIM:602068)
- Autosomal recessive inheritance (HP:0000007): A mode of inheritance that is observed for traits related to a gene encoded on one of the autosomes (i.e., the human chromosomes 1-22) in which a trait manifests in individuals with two pathogenic alleles, either homozygotes (two copies of the same mutant allele) or compound heterozygotes (whereby each copy of a gene has a distinct mutant allele). Evidence: IEA. (OMIM:602068)
- Typified by age-related disease onset (HP:0003831): Description of conditions in which age of onset is typically later in life and in which penetrance is dependent on the age of the subject. Evidence: IEA. (OMIM:602068)